- Recurrent urinary tract infections (HP:0000010): Repeated infections of the urinary tract. Evidence: TAS. Frequency: Occasional (HP:0040283). (ORPHA:261330)
- Inguinal hernia (HP:0000023): Protrusion of the contents of the abdominal cavity through the inguinal canal. Evidence: TAS. Frequency: Occasional (HP:0040283). (ORPHA:261330)
- Narrow mouth (HP:0000160): Distance between the commissures of the mouth more than 2 SD below the mean. Alternatively, an apparently decreased width of the oral aperture (subjective). Evidence: TAS. Frequency: Occasional (HP:0040283). (ORPHA:261330)
- Cleft palate (HP:0000175): Cleft palate is a developmental defect of the palate resulting from a failure of fusion of the palatine processes and manifesting as a separation of the roof of the mouth (soft and hard palate). Evidence: TAS. Frequency: Occasional (HP:0040283). (ORPHA:261330)
- Thin upper lip vermilion (HP:0000219): Height of the vermilion of the upper lip in the midline more than 2 SD below the mean. Alternatively, an apparently reduced height of the vermilion of the upper lip in the frontal view (subjective). Evidence: TAS. Frequency: Frequent (HP:0040282). (ORPHA:261330)
- Microcephaly (HP:0000252): Head circumference below 2 standard deviations below the mean for age and gender. Evidence: TAS. Frequency: Frequent (HP:0040282). (ORPHA:261330)
- Malar flattening (HP:0000272): Underdevelopment of the malar prominence of the jugal bone (zygomatic bone in mammals), appreciated in profile, frontal view, and/or by palpation. Evidence: TAS. Frequency: Occasional (HP:0040283). (ORPHA:261330)
- Long face (HP:0000276): Facial height (length) is more than 2 standard deviations above the mean (objective); or, an apparent increase in the height (length) of the face (subjective). Evidence: TAS. Frequency: Occasional (HP:0040283). (ORPHA:261330)
- Pointed chin (HP:0000307): A marked tapering of the lower face to the chin. Evidence: TAS. Frequency: Frequent (HP:0040282). (ORPHA:261330)
- Smooth philtrum (HP:0000319): Flat skin surface, with no ridge formation in the central region of the upper lip between the nasal base and upper vermilion border. Evidence: TAS. Frequency: Very frequent (HP:0040281). (ORPHA:261330)
- Facial asymmetry (HP:0000324): An abnormal difference between the left and right sides of the face. Evidence: TAS. Frequency: Occasional (HP:0040283). (ORPHA:261330)
- Abnormal earlobe morphology (HP:0000363): An abnormality of the lobule of pinna. Evidence: TAS. Frequency: Frequent (HP:0040282). (ORPHA:261330)
- Sensorineural hearing impairment (HP:0000407): A type of hearing impairment in one or both ears related to an abnormal functionality of the cochlear nerve. Evidence: TAS. Frequency: Occasional (HP:0040283). (ORPHA:261330)
- Prominent nasal bridge (HP:0000426): Anterior positioning of the nasal root in comparison to the usual positioning for age. Evidence: TAS. Frequency: Occasional (HP:0040283). (ORPHA:261330)
- Underdeveloped nasal alae (HP:0000430): Thinned, deficient, or excessively arched ala nasi. Evidence: TAS. Frequency: Frequent (HP:0040282). (ORPHA:261330)
- Choanal atresia (HP:0000453): Absence or abnormal closure of the choana (the posterior nasal aperture). Most embryologists believe that posterior choanal atresia results from a failure of rupture between the 35th and 38th day of fetal life of the partition which separates the bucconasal or buccopharyngeal membranes. The resultant choanal atresia may be unilateral or bilateral, bony or membranous, complete or incomplete. In over 90 per cent of cases the obstruction is bony, while in the remainder it is membranous. The bony type of atresia is commonly located 1-2 mm. anterior to the posterior edge of the hard palate, and the osseous septum varies in thickness from 1 to 10 mm. In the membranous form of choanal atresia the obstruction usually occurs further posteriorly. In approximately one third of cases the atresia is bilateral. Evidence: TAS. Frequency: Occasional (HP:0040283). (ORPHA:261330)
- Deeply set eye (HP:0000490): An eye that is more deeply recessed into the plane of the face than is typical. Evidence: TAS. Frequency: Frequent (HP:0040282). (ORPHA:261330)
- Blepharophimosis (HP:0000581): A fixed reduction in the vertical distance between the upper and lower eyelids with short palpebral fissures. Evidence: TAS. Frequency: Occasional (HP:0040283). (ORPHA:261330)
- Oculomotor apraxia (HP:0000657): Ocular motor apraxia is a deficiency in voluntary, horizontal, lateral, fast eye movements (saccades) with retention of slow pursuit movements. The inability to follow objects visually is often compensated by head movements. There may be decreased smooth pursuit, and cancelation of the vestibulo-ocular reflex. Evidence: TAS. Frequency: Occasional (HP:0040283). (ORPHA:261330)
- Depression (HP:0000716): Frequently experiencing feelings of being down, miserable, and/or hopeless; struggling to recover from these moods; having a pessimistic outlook on the future; feeling a pervasive sense of shame; having a low self-worth; experiencing thoughts of suicide and engaging in suicidal behavior. Evidence: TAS. Frequency: Occasional (HP:0040283). (ORPHA:261330)
- Compulsive behaviors (HP:0000722): Behavior that consists of repetitive acts, characterized by the feeling that one "has to" perform them, while being aware that these acts are not in line with one's overall goal. Evidence: TAS. Frequency: Occasional (HP:0040283). (ORPHA:261330)
- Arachnodactyly (HP:0001166): Abnormally long and slender fingers (spider fingers). Evidence: TAS. Frequency: Occasional (HP:0040283). (ORPHA:261330)
- Intellectual disability (HP:0001249): The term intellectual disability or intellectual developmental disorder is used to describe significantly sub-average intellectual and adaptive functioning based on clinical assessment and as measured by individually administered, appropriately normed, standardized and validated tests of intellectual functioning and adaptive behavior, with onset during the developmental period from infancy through adolescence. Evidence: TAS. Frequency: Very frequent (HP:0040281). (ORPHA:261330)
- Seizure (HP:0001250): A seizure is an intermittent abnormality of nervous system physiology characterized by a transient occurrence of signs and/or symptoms due to abnormal excessive or synchronous neuronal activity in the brain. Evidence: TAS. Frequency: Occasional (HP:0040283). (ORPHA:261330)
- Global developmental delay (HP:0001263): A delay in the achievement of motor or mental milestones in the domains of development of a child, including motor skills, speech and language, cognitive skills, and social and emotional skills. This term should only be used to describe children younger than five years of age. Evidence: TAS. Frequency: Very frequent (HP:0040281). (ORPHA:261330)
- Growth delay (HP:0001510): A deficiency or slowing down of growth pre- and postnatally. Evidence: TAS. Frequency: Occasional (HP:0040283). (ORPHA:261330)
- Intrauterine growth retardation (HP:0001511): An abnormal restriction of fetal growth with fetal weight below the tenth percentile for gestational age. Evidence: TAS. Frequency: Frequent (HP:0040282). (ORPHA:261330)
- Premature birth (HP:0001622): The birth of a baby of less than 37 weeks of gestational age. Evidence: TAS. Frequency: Very frequent (HP:0040281). (ORPHA:261330)
- Ventricular septal defect (HP:0001629): A hole between the two bottom chambers (ventricles) of the heart. The defect is centered around the most superior aspect of the ventricular septum. Evidence: TAS. Frequency: Occasional (HP:0040283). (ORPHA:261330)
- Atrial septal defect (HP:0001631): Atrial septal defect (ASD) is a congenital abnormality of the interatrial septum that enables blood flow between the left and right atria via the interatrial septum. Evidence: TAS. Frequency: Occasional (HP:0040283). (ORPHA:261330)
- Aortic regurgitation (HP:0001659): An insufficiency of the aortic valve, leading to regurgitation (backward flow) of blood from the aorta into the left ventricle. Evidence: TAS. Frequency: Occasional (HP:0040283). (ORPHA:261330)
- Truncus arteriosus (HP:0001660): A single arterial trunk arises from the cardiac mass. The pulmonary arteries, aorta and coronary arteries arise from this single trunk with no evidence of another outflow tract. Evidence: TAS. Frequency: Frequent (HP:0040282). (ORPHA:261330)
- Pes planus (HP:0001763): A foot where the longitudinal arch of the foot is in contact with the ground or floor when the individual is standing; or, in a patient lying supine, a foot where the arch is in contact with the surface of a flat board pressed against the sole of the foot by the examiner with a pressure similar to that expected from weight bearing; or, the height of the arch is reduced. Evidence: TAS. Frequency: Frequent (HP:0040282). (ORPHA:261330)
- Toe syndactyly (HP:0001770): Webbing or fusion of the toes, involving soft parts only or including bone structure. Bony fusions are referred to as "bony" Syndactyly if the fusion occurs in a radio-ulnar axis. Fusions of bones of the toes in a proximo-distal axis are referred to as "Symphalangism". Evidence: TAS. Frequency: Occasional (HP:0040283). (ORPHA:261330)
- Absent toenail (HP:0001802): Congenital absence of the toenail. Evidence: TAS. Frequency: Frequent (HP:0040282). (ORPHA:261330)
- Absent fingernail (HP:0001817): Absence of a fingernail. Evidence: TAS. Frequency: Frequent (HP:0040282). (ORPHA:261330)
- Sandal gap (HP:0001852): A widely spaced gap between the first toe (the great toe) and the second toe. Evidence: TAS. Frequency: Occasional (HP:0040283). (ORPHA:261330)
- Pyloric stenosis (HP:0002021): Pyloric stenosis, also known as infantile hypertrophic pyloric stenosis, is an uncommon condition in infants characterized by abnormal thickening of the pylorus muscles in the stomach leading to gastric outlet obstruction. Clinically infants are well at birth. Then, at 3 to 6 weeks of age, the infants present with projectile vomiting, potentially leading to dehydration and weight loss. Evidence: TAS. Frequency: Occasional (HP:0040283). (ORPHA:261330)
- Recurrent respiratory infections (HP:0002205): An increased susceptibility to respiratory infections as manifested by a history of recurrent respiratory infections. Evidence: TAS. Frequency: Occasional (HP:0040283). (ORPHA:261330)
- Language impairment (HP:0002463): Language impairment is a deficit in comprehension or production of language that includes reduced vocabulary, limited sentence structure, or impairments in written or spoken communication. Language abilities are substantially and quantifiably below age expectations. Evidence: TAS. Frequency: Very frequent (HP:0040281). (ORPHA:261330)
- Highly arched eyebrow (HP:0002553): Increased height of the central portion of the eyebrow, forming a crescent, semicircular, or inverted U shape. Evidence: TAS. Frequency: Very frequent (HP:0040281). (ORPHA:261330)
- Bowel incontinence (HP:0002607): Involuntary fecal soiling in adults and children who have usually already been toilet trained. Evidence: TAS. Frequency: Occasional (HP:0040283). (ORPHA:261330)
- Neoplasm (HP:0002664): An organ or organ-system abnormality that consists of uncontrolled autonomous cell-proliferation which can occur in any part of the body as a benign or malignant neoplasm (tumor). Evidence: TAS. Frequency: Frequent (HP:0040282). (ORPHA:261330)
- Coxa valga (HP:0002673): Coxa valga is a deformity of the hip in which the angle between the femoral shaft and the femoral neck is increased compared to age-adjusted values (about 150 degrees in newborns gradually reducing to 120-130 degrees in adults). Evidence: TAS. Frequency: Occasional (HP:0040283). (ORPHA:261330)
- High, narrow palate (HP:0002705): The presence of a high and narrow palate. Evidence: TAS. Frequency: Occasional (HP:0040283). (ORPHA:261330)
- Immunodeficiency (HP:0002721): Failure of the immune system to protect the body adequately from infection, due to the absence or insufficiency of some component process or substance. Evidence: TAS. Frequency: Occasional (HP:0040283). (ORPHA:261330)
- Hyperlordosis (HP:0003307): Abnormally increased curvature (anterior concavity) of the lumbar or cervical spine. Evidence: TAS. Frequency: Occasional (HP:0040283). (ORPHA:261330)
- Clinodactyly of the 5th finger (HP:0004209): Clinodactyly refers to a bending or curvature of the fifth finger in the radial direction (i.e., towards the 4th finger). Evidence: TAS. Frequency: Frequent (HP:0040282). (ORPHA:261330)
- Short palm (HP:0004279): Short palm. Evidence: TAS. Frequency: Occasional (HP:0040283). (ORPHA:261330)
- Short stature (HP:0004322): A height below that which is expected according to age and gender norms. Although there is no universally accepted definition of short stature, many refer to "short stature" as height more than 2 standard deviations below the mean for age and gender (or below the 3rd percentile for age and gender dependent norms). Evidence: TAS. Frequency: Very frequent (HP:0040281). (ORPHA:261330)
- Aortic aneurysm (HP:0004942): Aortic dilatation refers to a dimension that is greater than the 95th percentile for the normal person age, sex and body size. In contrast, an aneurysm is defined as a localized dilation of the aorta that is more than 150 percent of predicted (ratio of observed to expected diameter 1.5 or more). Aneurysm should be distinguished from ectasia, which represents a diffuse dilation of the aorta less than 50 percent of normal aorta diameter. Evidence: TAS. Frequency: Occasional (HP:0040283). (ORPHA:261330)
- Bowing of the long bones (HP:0006487): A bending or abnormal curvature of a long bone. Evidence: TAS. Frequency: Occasional (HP:0040283). (ORPHA:261330)
- Attention deficit hyperactivity disorder (HP:0007018): Attention deficit hyperactivity disorder (ADHD) manifests at age 2-3 years or by first grade at the latest. The main symptoms are distractibility, impulsivity, hyperactivity, and often trouble organizing tasks and projects, difficulty going to sleep, and social problems from being aggressive, loud, or impatient. Evidence: TAS. Frequency: Occasional (HP:0040283). (ORPHA:261330)
- Ulnar deviation of finger (HP:0009465): Bending or curvature of a finger toward the ulnar side (i.e., away from the thumb). The deviation is at the metacarpal-phalangeal joint, and this finding is distinct from clinodactyly. Evidence: TAS. Frequency: Occasional (HP:0040283). (ORPHA:261330)
- Branchial fistula (HP:0009795): A congenital fistula in the neck resulting from incomplete closure of a branchial cleft. Evidence: TAS. Frequency: Occasional (HP:0040283). (ORPHA:261330)
- Short distal phalanx of finger (HP:0009882): Short distance from the end of the finger to the most distal interphalangeal crease or the distal interphalangeal joint flexion point. That is, hypoplasia of one or more of the distal phalanx of finger. Evidence: TAS. Frequency: Occasional (HP:0040283). (ORPHA:261330)
- Ankyloglossia (HP:0010296): Short or anteriorly attached lingual frenulum, associated with limited mobility of the tongue. Evidence: TAS. Frequency: Occasional (HP:0040283). (ORPHA:261330)
- Tics (HP:0100033): Repeated, individually recognizable, intermittent movements or movement fragments that are almost always briefly suppressible and are usually associated with awareness of an urge to perform the movement. Evidence: TAS. Frequency: Occasional (HP:0040283). (ORPHA:261330)
- Camptodactyly of finger (HP:0100490): The distal interphalangeal joint and/or the proximal interphalangeal joint of the fingers cannot be extended to 180 degrees by either active or passive extension. Evidence: TAS. Frequency: Occasional (HP:0040283). (ORPHA:261330)
- Joint hypermobility (HP:0001382): The capability that a joint (or a group of joints) has to move, passively and/or actively, beyond normal limits along physiological axes. Evidence: TAS. Frequency: Occasional (HP:0040283). (ORPHA:261330)
These phenotypes are associated with the disease Distal 22q11.2 microdeletion syndrome (ORPHA:261330).